Phenotypes associated with the disease autosomal recessive nonsyndromic hearing loss 103 (OMIM:616042):
- Abnormal vestibular function (HP:0001751): An abnormality of the functioning of the vestibular apparatus. Evidence: PCS. Frequency: 2/2. (PMID:24781754)
- Sensorineural hearing impairment (HP:0000407): A type of hearing impairment in one or both ears related to an abnormal functionality of the cochlear nerve. Evidence: PCS. Frequency: 2/2. (PMID:24781754)
- Childhood onset (HP:0011463): Onset of disease at the age of between 1 and 5 years. Evidence: PCS. Frequency: 2/2. (PMID:24781754)
- Autosomal recessive inheritance (HP:0000007): A mode of inheritance that is observed for traits related to a gene encoded on one of the autosomes (i.e., the human chromosomes 1-22) in which a trait manifests in individuals with two pathogenic alleles, either homozygotes (two copies of the same mutant allele) or compound heterozygotes (whereby each copy of a gene has a distinct mutant allele). Evidence: PCS. (PMID:24781754)
- Vestibular areflexia (HP:0008568): Vestibular areflexia can be measured as the absence of the caloric nystagmus response in electronystagmography. Evidence: PCS. Frequency: 2/2. (PMID:24781754)